Phenotypes associated with the disease Ocular albinism with late-onset sensorineural deafness (ORPHA:1000):
- Sensorineural hearing impairment (HP:0000407): A type of hearing impairment in one or both ears related to an abnormal functionality of the cochlear nerve. Evidence: TAS. Frequency: Very frequent (HP:0040281). (ORPHA:1000)
- Strabismus (HP:0000486): A misalignment of the eyes so that the visual axes deviate from bifoveal fixation. The classification of strabismus may be based on a number of features including the relative position of the eyes, whether the deviation is latent or manifest, intermittent or constant, concomitant or otherwise and according to the age of onset and the relevance of any associated refractive error. Evidence: TAS. Frequency: Frequent (HP:0040282). (ORPHA:1000)
- Visual impairment (HP:0000505): Visual impairment (or vision impairment) is vision loss (of a person) to such a degree as to qualify as an additional support need through a significant limitation of visual capability resulting from either disease, trauma, or congenital or degenerative conditions that cannot be corrected by conventional means, such as refractive correction, medication, or surgery. Evidence: TAS. Frequency: Very frequent (HP:0040281). (ORPHA:1000)
- Photophobia (HP:0000613): Excessive sensitivity to light with the sensation of discomfort or pain in the eyes due to exposure to bright light. Evidence: TAS. Frequency: Very frequent (HP:0040281). (ORPHA:1000)
- Nystagmus (HP:0000639): Rhythmic, involuntary oscillations of one or both eyes related to abnormality in fixation, conjugate gaze, or vestibular mechanisms. Evidence: TAS. Frequency: Very frequent (HP:0040281). (ORPHA:1000)
- Ocular albinism (HP:0001107): An abnormal reduction in the amount of pigmentation (reduced or absent) of the iris and retina. Evidence: TAS. Frequency: Very frequent (HP:0040281). (ORPHA:1000)